Phenotypes associated with the disease X-linked intellectual disability, Porteous type (ORPHA:93945):
- Mild intellectual disability (HP:0001256): Mild intellectual disability (ID) is defined as a type of ID characterized by mildly sub-average adaptive functioning and intellectual functioning, with an intelligence quotient (IQ) the range of 50-69. Evidence: TAS. Frequency: Very frequent (HP:0040281). (ORPHA:93945)
- Global developmental delay (HP:0001263): A delay in the achievement of motor or mental milestones in the domains of development of a child, including motor skills, speech and language, cognitive skills, and social and emotional skills. This term should only be used to describe children younger than five years of age. Evidence: TAS. Frequency: Very frequent (HP:0040281). (ORPHA:93945)
- Narrow face (HP:0000275): Bizygomatic (upper face) and bigonial (lower face) width are both more than 2 standard deviations below the mean (objective); or, an apparent reduction in the width of the upper and lower face (subjective). Evidence: TAS. Frequency: Frequent (HP:0040282). (ORPHA:93945)
- Long face (HP:0000276): Facial height (length) is more than 2 standard deviations above the mean (objective); or, an apparent increase in the height (length) of the face (subjective). Evidence: TAS. Frequency: Frequent (HP:0040282). (ORPHA:93945)
- Mandibular prognathia (HP:0000303): Abnormal prominence of the chin related to increased length of the mandible. Evidence: TAS. Frequency: Frequent (HP:0040282). (ORPHA:93945)
- Short philtrum (HP:0000322): Distance between nasal base and midline upper lip vermilion border more than 2 SD below the mean. Alternatively, an apparently decreased distance between nasal base and midline upper lip vermilion border. Evidence: TAS. Frequency: Frequent (HP:0040282). (ORPHA:93945)
- Hypoplasia of the maxilla (HP:0000327): Abnormally small dimension of the Maxilla. Usually creating a malocclusion or malalignment between the upper and lower teeth or resulting in a deficient amount of projection of the base of the nose and lower midface region. Evidence: TAS. Frequency: Frequent (HP:0040282). (ORPHA:93945)
- Cupped ear (HP:0000378): Laterally protruding ear that lacks antihelical folding (including absence of inferior and superior crura). Evidence: TAS. Frequency: Frequent (HP:0040282). (ORPHA:93945)
- Macrotia (HP:0000400): Median longitudinal ear length greater than two standard deviations above the mean and median ear width greater than two standard deviations above the mean (objective); or, apparent increase in length and width of the pinna (subjective). Evidence: TAS. Frequency: Frequent (HP:0040282). (ORPHA:93945)
- Bulbous nose (HP:0000414): Increased volume and globular shape of the anteroinferior aspect of the nose. Evidence: TAS. Frequency: Frequent (HP:0040282). (ORPHA:93945)
- Strabismus (HP:0000486): A misalignment of the eyes so that the visual axes deviate from bifoveal fixation. The classification of strabismus may be based on a number of features including the relative position of the eyes, whether the deviation is latent or manifest, intermittent or constant, concomitant or otherwise and according to the age of onset and the relevance of any associated refractive error. Evidence: TAS. Frequency: Frequent (HP:0040282). (ORPHA:93945)
- Frontal balding (HP:0002292): Absence of hair in the anterior midline and/or parietal areas. Evidence: TAS. Frequency: Frequent (HP:0040282). (ORPHA:93945)
- Short stature (HP:0004322): A height below that which is expected according to age and gender norms. Although there is no universally accepted definition of short stature, many refer to "short stature" as height more than 2 standard deviations below the mean for age and gender (or below the 3rd percentile for age and gender dependent norms). Evidence: TAS. Frequency: Frequent (HP:0040282). (ORPHA:93945)
- Decreased body weight (HP:0004325): Abnormally low body weight. Evidence: TAS. Frequency: Frequent (HP:0040282). (ORPHA:93945)